- Autosomal recessive inheritance (HP:0000007): A mode of inheritance that is observed for traits related to a gene encoded on one of the autosomes (i.e., the human chromosomes 1-22) in which a trait manifests in individuals with two pathogenic alleles, either homozygotes (two copies of the same mutant allele) or compound heterozygotes (whereby each copy of a gene has a distinct mutant allele). Evidence: PCS. (PMID:22931863)
- Moyamoya phenomenon (HP:0011834): A noninflammatory, progressive occlusion of the intracranial carotid arteries owing to the formation of netlike collateral arteries arising from the circle of Willis. Evidence: PCS. Frequency: 4/4. Onset: Juvenile onset (HP:0003621). (PMID:21799892)
- Moyamoya phenomenon (HP:0011834): A noninflammatory, progressive occlusion of the intracranial carotid arteries owing to the formation of netlike collateral arteries arising from the circle of Willis. Evidence: PCS. (PMID:22931863)
- Transient ischemic attack (HP:0002326). Evidence: PCS. (PMID:22931863)
- Autosomal dominant inheritance (HP:0000006): A mode of inheritance that is observed for traits related to a gene encoded on one of the autosomes (i.e., the human chromosomes 1-22) in which a trait manifests in heterozygotes. In the context of medical genetics, an autosomal dominant disorder is caused when a single copy of the mutant allele is present. Males and females are affected equally, and can both transmit the disorder with a risk of 50% for each child of inheriting the mutant allele. Evidence: PCS. (PMID:21799892)
These phenotypes are associated with the disease Moyamoya disease 2 (OMIM:607151).